Phenotypes associated with the disease intellectual developmental disorder, autosomal dominant 74 (OMIM:620688):
- Bilateral tonic-clonic seizure (HP:0002069): A bilateral tonic-clonic seizure is a seizure defined by a tonic (bilateral increased tone, lasting seconds to minutes) and then a clonic (bilateral sustained rhythmic jerking) phase. Evidence: PCS. Frequency: 2/13. (PMID:37541189)
- Hypertonia (HP:0001276): A condition in which there is increased muscle tone so that arms or legs, for example, are stiff and difficult to move. Evidence: PCS. Frequency: 1/12. (PMID:37541189)
- Delayed CNS myelination (HP:0002188): Delayed myelination in the central nervous system. Evidence: PCS. Frequency: 1/10. (PMID:37541189)
- Mild intellectual disability (HP:0001256): Mild intellectual disability (ID) is defined as a type of ID characterized by mildly sub-average adaptive functioning and intellectual functioning, with an intelligence quotient (IQ) the range of 50-69. Evidence: PCS. Frequency: 4/4. (PMID:37541189)
- Moderate intellectual disability (HP:0002342): Moderate intellectual disability (ID) is defined as a type of ID characterized by moderately sub-average adaptive functioning and intellectual functioning, with an intelligence quotient (IQ) the range of 35-49. Evidence: PCS. Frequency: 2/2. (PMID:37541189)
- Hypotonia (HP:0001252): Hypotonia is an abnormally low muscle tone (the amount of tension or resistance to movement in a muscle). Even when relaxed, muscles have a continuous and passive partial contraction which provides some resistance to passive stretching. Hypotonia thus manifests as diminished resistance to passive stretching. Hypotonia is not the same as muscle weakness, although the two conditions can co-exist. Evidence: PCS. Frequency: 7/12. (PMID:37541189)
- Sleep disturbance (HP:0002360): An abnormal pattern in the quality, quantity, or characteristics of sleep. Evidence: PCS. Frequency: 6/6. (PMID:37541189)
- Infantile onset (HP:0003593): Onset of signs or symptoms of disease between 28 days to one year of life. Evidence: PCS. Frequency: 13/13. (PMID:37541189)
- Delayed fine motor development (HP:0010862): A type of motor delay characterized by a delay in acquiring the ability to control the fingers and hands. Evidence: PCS. Frequency: 11/12. (PMID:37541189)
- Happy demeanor (HP:0040082): A conspicuously happy disposition, characterized by frequent smiling and laughing, which may be contextually inappropriate or unrelated to the situation. Evidence: PCS. Frequency: 7/12. (PMID:37541189)
- Diminished ability to concentrate (HP:0031987): The inability to focus or concentrate on a specific task, activity, or object. The subject may find themselves unable to grasp or understand written text and re-reads frequently without understanding. Familiar tasks or activities are severely compromised due to the lack of ability to concentrate. Thinking through multi-step problems is typically very difficult or impossible, leading to avoidance of such activities. Evidence: PCS. Frequency: 5/13. (PMID:37541189)
- Motor tics (HP:0100034): Movement-based tics affecting discrete muscle groups. Evidence: PCS. Frequency: 2/12. (PMID:37541189)
- Severe intellectual disability (HP:0010864): Severe intellectual disability (ID) is defined as a type of ID characterized by severely sub-average adaptive functioning and intellectual functioning, with an intelligence quotient (IQ) the range of 20-34. Evidence: PCS. Frequency: 2/2. (PMID:37541189)
- Smooth philtrum (HP:0000319): Flat skin surface, with no ridge formation in the central region of the upper lip between the nasal base and upper vermilion border. Evidence: PCS. Frequency: 6/13. (PMID:37541189)
- Hypertelorism (HP:0000316): Interpupillary distance more than 2 SD above the mean (alternatively, the appearance of an increased interpupillary distance or widely spaced eyes). Evidence: PCS. Frequency: 2/13. (PMID:37541189)
- Thin upper lip vermilion (HP:0000219): Height of the vermilion of the upper lip in the midline more than 2 SD below the mean. Alternatively, an apparently reduced height of the vermilion of the upper lip in the frontal view (subjective). Evidence: PCS. Frequency: 10/13. (PMID:37541189)
- Round face (HP:0000311): The facial appearance is more circular than usual as viewed from the front. Evidence: PCS. Frequency: 2/13. (PMID:37541189)
- Microcephaly (HP:0000252): Head circumference below 2 standard deviations below the mean for age and gender. Evidence: PCS. Frequency: 3/13. (PMID:37541189)
- Downslanted palpebral fissures (HP:0000494): The palpebral fissure inclination is more than two standard deviations below the mean. Evidence: PCS. Frequency: 2/13. (PMID:37541189)
- Delayed speech and language development (HP:0000750): A degree of language development that is significantly below the norm for a child of a specified age. Evidence: PCS. Frequency: 8/8. (PMID:37541189)
- Absent speech (HP:0001344): Complete lack of development of speech and language abilities. Evidence: PCS. Frequency: 3/11. (PMID:37541189)
- Obstructive sleep apnea (HP:0002870): Obstructive Sleep Apnea is a condition characterized by the obstruction of the airway and pauses in breathing during sleep, which occur multiple times throughout the night. It is related to the relaxation of muscle tone that typically happens during sleep, leading to a partial collapse of the soft tissues in the airway and causing airflow obstruction. Evidence: PCS. Frequency: 3/12. (PMID:37541189)
- Delayed ability to walk (HP:0031936): A failure to achieve the ability to walk at an appropriate developmental stage. Most children learn to walk in a series of stages, and learn to walk short distances independently between 12 and 15 months. Evidence: PCS. Frequency: 8/12. (PMID:37541189)
- Feeding difficulties (HP:0011968): Impaired ability to eat related to problems gathering food and getting ready to suck, chew, or swallow it. Evidence: PCS. Frequency: 9/12. (PMID:37541189)
- Deeply set eye (HP:0000490): An eye that is more deeply recessed into the plane of the face than is typical. Evidence: PCS. Frequency: 7/13. (PMID:37541189)
- Global developmental delay (HP:0001263): A delay in the achievement of motor or mental milestones in the domains of development of a child, including motor skills, speech and language, cognitive skills, and social and emotional skills. This term should only be used to describe children younger than five years of age. Evidence: PCS. Frequency: 13/13. (PMID:37541189)
- Delayed gross motor development (HP:0002194): A type of motor delay characterized by a delay in acquiring the ability to control the large muscles of the body for walking, running, sitting, and crawling. Evidence: PCS. Frequency: 4/4. (PMID:37541189)
- Typical absence seizure (HP:0011147): A typical absence seizure is a type of generalized non-motor (absence) seizure characterized by its sudden onset, interruption of ongoing activities, a blank stare, possibly a brief upward deviation of the eyes. Usually the patient will be unresponsive when spoken to. Duration is a few seconds to half a minute with very rapid recovery. Although not always available, an EEG would usually show 3 Hz generalized epileptiform discharges during the event. Evidence: PCS. Frequency: 1/13. (PMID:37541189)
- Prominent nose (HP:0000448): Distance between subnasale and pronasale more than two standard deviations above the mean, or alternatively, an apparently increased anterior protrusion of the nasal tip. Evidence: PCS. Frequency: 1/13. (PMID:37541189)
- Hypotelorism (HP:0000601): Interpupillary distance less than 2 SD below the mean (alternatively, the appearance of an decreased interpupillary distance or closely spaced eyes). Evidence: PCS. Frequency: 1/13. (PMID:37541189)
- Intrauterine growth retardation (HP:0001511): An abnormal restriction of fetal growth with fetal weight below the tenth percentile for gestational age. Evidence: PCS. Frequency: 1/12. (PMID:37541189)
- Brachycephaly (HP:0000248): An abnormality of skull shape characterized by a decreased anterior-posterior diameter. That is, a cephalic index greater than 81%. Alternatively, an apparently shortened anteroposterior dimension (length) of the head compared to width. Evidence: PCS. Frequency: 2/13. (PMID:37541189)
- Autosomal dominant inheritance (HP:0000006): A mode of inheritance that is observed for traits related to a gene encoded on one of the autosomes (i.e., the human chromosomes 1-22) in which a trait manifests in heterozygotes. In the context of medical genetics, an autosomal dominant disorder is caused when a single copy of the mutant allele is present. Males and females are affected equally, and can both transmit the disorder with a risk of 50% for each child of inheriting the mutant allele. Evidence: PCS. (PMID:37541189)